- Adult onset (HP:0003581): Onset of disease manifestations in adulthood, defined here as at the age of 16 years or later. Evidence: IEA. (PMID:11001884)
- Cirrhosis (HP:0001394): A chronic disorder of the liver in which liver tissue becomes scarred and is partially replaced by regenerative nodules and fibrotic tissue resulting in loss of liver function. Evidence: PCS. Frequency: 6/43. (PMID:11001884)
- Budd-Chiari syndrome (HP:0002639): Budd-Chiari syndrome (BCS) is caused by obstruction of hepatic venous outflow at any level from the small hepatic veins to the junction of the inferior vena cava (IVC) with the right atrium, 1 and occurs in 1/100,000 of the general population worldwide. The most common presentation is with ascites, but can range from fulminant hepatic failure (FHF) to asymptomatic forms. Obstruction of hepatic venous outflow is mainly caused by primary intravascular thrombosis, which can occur suddenly or be repeated over time, accompanied by some revascularization, accounting for the variable parenchymal hepatic damage and histologic presentation. Budd-Chiari syndrome is thus a disease, but since it occurs as a manifestation of several other diseases, this term is kept for the present for convenience. Evidence: PCS. (PMID:11001884)
- Autosomal recessive inheritance (HP:0000007): A mode of inheritance that is observed for traits related to a gene encoded on one of the autosomes (i.e., the human chromosomes 1-22) in which a trait manifests in individuals with two pathogenic alleles, either homozygotes (two copies of the same mutant allele) or compound heterozygotes (whereby each copy of a gene has a distinct mutant allele). Evidence: PCS. (PMID:11001884)
- Hepatocellular carcinoma (HP:0001402): A kind of neoplasm of the liver that originates in hepatocytes and presents macroscopically as a soft and hemorrhagic tan mass in the liver. Evidence: IEA. (OMIM:600880)
These phenotypes are associated with the disease Budd-Chiari syndrome (OMIM:600880).